- Clinodactyly of the 5th finger (HP:0004209): Clinodactyly refers to a bending or curvature of the fifth finger in the radial direction (i.e., towards the 4th finger). Evidence: IEA. (OMIM:148520)
- Autosomal dominant inheritance (HP:0000006): A mode of inheritance that is observed for traits related to a gene encoded on one of the autosomes (i.e., the human chromosomes 1-22) in which a trait manifests in heterozygotes. In the context of medical genetics, an autosomal dominant disorder is caused when a single copy of the mutant allele is present. Males and females are affected equally, and can both transmit the disorder with a risk of 50% for each child of inheriting the mutant allele. Evidence: IEA. (OMIM:148520)
- Abnormality of the skin (HP:0000951): An abnormality of the skin. Evidence: IEA. (OMIM:148520)
These phenotypes are associated with the disease keratosis palmaris et plantaris-clinodactyly syndrome (OMIM:148520).